- Ascites (HP:0001541): Accumulation of fluid in the peritoneal cavity (between the layers of the peritoneum that lines the abdomen). Evidence: TAS. Frequency: Occasional (HP:0040283). (ORPHA:83469)
- Weight loss (HP:0001824): Reduction of total body weight. Evidence: TAS. Frequency: Frequent (HP:0040282). (ORPHA:83469)
- Anemia (HP:0001903): A reduction in erythrocytes volume or hemoglobin concentration. Evidence: TAS. Frequency: Occasional (HP:0040283). (ORPHA:83469)
- Nausea and vomiting (HP:0002017): Nausea is a commonly encountered symptom that has been defined as an unpleasant painless subjective feeling that one will imminently vomit. Vomiting has been defined as the forceful expulsion of the contents of the stomach, duodenum, or jejunum through the oral cavity. While nausea and vomiting are often thought to exist on a temporal continuum, this is not always the case. There are situations when severe nausea may be present without emesis and less frequently, when emesis may be present without preceding nausea. Evidence: TAS. Frequency: Frequent (HP:0040282). (ORPHA:83469)
- Abdominal pain (HP:0002027): An unpleasant sensation characterized by physical discomfort (such as pricking, throbbing, or aching) and perceived to originate in the abdomen. Evidence: TAS. Frequency: Very frequent (HP:0040281). (ORPHA:83469)
- Hepatomegaly (HP:0002240): Abnormally increased size of the liver. Evidence: TAS. Frequency: Frequent (HP:0040282). (ORPHA:83469)
- Abnormal peritoneum morphology (HP:0002585): An abnormality of the peritoneum. Evidence: TAS. Frequency: Very frequent (HP:0040281). (ORPHA:83469)
- Ileus (HP:0002595): Acute obstruction of the intestines preventing passage of the contents of the intestines. Evidence: TAS. Frequency: Frequent (HP:0040282). (ORPHA:83469)
- Lymphadenopathy (HP:0002716): Enlargement (swelling) of a lymph node. Evidence: TAS. Frequency: Very frequent (HP:0040281). (ORPHA:83469)
- Neoplasm of the pancreas (HP:0002894): A tumor (abnormal growth of tissue) of the pancreas. Evidence: TAS. Frequency: Occasional (HP:0040283). (ORPHA:83469)
- Abdominal distention (HP:0003270): Distention of the abdomen. Evidence: TAS. Frequency: Very frequent (HP:0040281). (ORPHA:83469)
- Cachexia (HP:0004326): Severe weight loss, wasting of muscle, loss of appetite, and general debility related to a chronic disease. Evidence: TAS. Frequency: Occasional (HP:0040283). (ORPHA:83469)
- Testicular neoplasm (HP:0010788): The presence of a neoplasm of the testis. Evidence: TAS. Frequency: Occasional (HP:0040283). (ORPHA:83469)
- Neoplasm of the central nervous system (HP:0100006): A neoplasm of the central nervous system. Evidence: TAS. Frequency: Occasional (HP:0040283). (ORPHA:83469)
- Sarcoma (HP:0100242): A connective tissue neoplasm formed by proliferation of mesodermal cells. Bone and soft tissue sarcomas are the main types of sarcoma. Sarcoma is usually highly malignant. Evidence: TAS. Frequency: Very frequent (HP:0040281). (ORPHA:83469)
- Neoplasm of the lung (HP:0100526): Tumor of the lung. Evidence: TAS. Frequency: Occasional (HP:0040283). (ORPHA:83469)
- Ovarian neoplasm (HP:0100615): A tumor (abnormal growth of tissue) of the ovary. Evidence: TAS. Frequency: Occasional (HP:0040283). (ORPHA:83469)
- Mediastinal lymphadenopathy (HP:0100721): Swelling of lymph nodes within the mediastinum, the central compartment of the thoracic cavities that contains the heart and the great vessels, the esophagus, and trachea and other structures including lymph nodes. Evidence: TAS. Frequency: Frequent (HP:0040282). (ORPHA:83469)
These phenotypes are associated with the disease Desmoplastic small round cell tumor (ORPHA:83469).